Phenotypes associated with the disease myoclonic epilepsy, Hartung type (OMIM:159600):
- Generalized myoclonic seizure (HP:0002123): A generalized myoclonic seizure is a type of generalized motor seizure characterized by bilateral, sudden, brief (<100 ms) involuntary single or multiple contraction of muscles or muscle groups of variable topography (axial, proximal limb, distal). Myoclonus is less regularly repetitive and less sustained than is clonus. Evidence: TAS. (OMIM:159600)
- Autosomal dominant inheritance (HP:0000006): A mode of inheritance that is observed for traits related to a gene encoded on one of the autosomes (i.e., the human chromosomes 1-22) in which a trait manifests in heterozygotes. In the context of medical genetics, an autosomal dominant disorder is caused when a single copy of the mutant allele is present. Males and females are affected equally, and can both transmit the disorder with a risk of 50% for each child of inheriting the mutant allele. Evidence: TAS. (OMIM:159600)